- Polycythemia (HP:0001901): Polycythemia is diagnosed if the red blood cell count, the hemoglobin level, and the red blood cell volume all exceed the upper limits of normal. Evidence: TAS. (OMIM:102900)
- Reduced erythrocyte 2,3-diphosphoglycerate concentration (HP:0030271): This term refers to an inappropriate low 2,3-DPG concentration in erythrocytes. 2,3-diphosphoglycerate (2,3-DPG) controls the movement of oxygen from red blood cells to tissues. Anemia is usually accompanied by an increased level of 2,3-DPG in order to promote tissue oxygenation. Evidence: TAS. (OMIM:102900)
- Autosomal dominant inheritance (HP:0000006): A mode of inheritance that is observed for traits related to a gene encoded on one of the autosomes (i.e., the human chromosomes 1-22) in which a trait manifests in heterozygotes. In the context of medical genetics, an autosomal dominant disorder is caused when a single copy of the mutant allele is present. Males and females are affected equally, and can both transmit the disorder with a risk of 50% for each child of inheriting the mutant allele. Evidence: TAS. (OMIM:102900)
These phenotypes are associated with the disease pyruvate kinase hyperactivity (OMIM:102900).